Phenotypes associated with the disease Autoimmune hemolytic anemia, warm type (ORPHA:90033):
- Pallor (HP:0000980): Abnormally pale skin. Evidence: TAS. Frequency: Very frequent (HP:0040281). (ORPHA:90033)
- Autoimmune hemolytic anemia (HP:0001890): An autoimmune form of hemolytic anemia. Evidence: TAS. Frequency: Very frequent (HP:0040281). (ORPHA:90033)
- Headache (HP:0002315): Cephalgia, or pain sensed in various parts of the head, not confined to the area of distribution of any nerve. Evidence: TAS. Frequency: Very frequent (HP:0040281). (ORPHA:90033)
- Exertional dyspnea (HP:0002875): Perceived difficulty to breathe that occurs with exercise or exertion and improves with rest. Evidence: TAS. Frequency: Very frequent (HP:0040281). (ORPHA:90033)
- Autoimmunity (HP:0002960): The occurrence of an immune reaction against the organism's own cells or tissues. Evidence: TAS. Frequency: Very frequent (HP:0040281). (ORPHA:90033)
- Fatigue (HP:0012378): A subjective feeling of tiredness characterized by a lack of energy and motivation. Evidence: TAS. Frequency: Very frequent (HP:0040281). (ORPHA:90033)
- Splenomegaly (HP:0001744): Abnormal increased size of the spleen. Evidence: TAS. Frequency: Frequent (HP:0040282). (ORPHA:90033)
- Reticulocytosis (HP:0001923): An elevation in the number of reticulocytes (immature erythrocytes) in the peripheral blood circulation. Evidence: TAS. Frequency: Frequent (HP:0040282). (ORPHA:90033)
- Palpitations (HP:0001962): A sensation that the heart is pounding or racing, which is a non-specific sign but may be a manifestation of arrhythmia. Evidence: TAS. Frequency: Frequent (HP:0040282). (ORPHA:90033)
- Arthralgia (HP:0002829): Joint pain. Evidence: TAS. Frequency: Frequent (HP:0040282). (ORPHA:90033)
- Hemoglobinuria (HP:0003641): The presence of free hemoglobin in the urine. Evidence: TAS. Frequency: Frequent (HP:0040282). (ORPHA:90033)
- Microspherocytosis (HP:0004835): The presence of erythrocytes that are sphere-shaped and reduced in size. Evidence: TAS. Frequency: Frequent (HP:0040282). (ORPHA:90033)
- Lymphoproliferative disorder (HP:0005523). Evidence: TAS. Frequency: Frequent (HP:0040282). (ORPHA:90033)
- Unconjugated hyperbilirubinemia (HP:0008282): An increased amount of unconjugated (indirect) bilurubin in the blood. Evidence: TAS. Frequency: Frequent (HP:0040282). (ORPHA:90033)
- Decreased hemoglobin concentration (HP:0020062): An abnormal reduction below normal hemoglobin concentration in the circulation. Evidence: TAS. Frequency: Frequent (HP:0040282). (ORPHA:90033)
- Decreased circulating haptoglobin concentration (HP:0020181): The concentration of haptoglobin in the blood circulation is below the lower limit of normal. Evidence: TAS. Frequency: Frequent (HP:0040282). (ORPHA:90033)
- Increased circulating lactate dehydrogenase concentration (HP:0025435): An elevated level of the enzyme lactate dehydrogenase in the blood circulation. Evidence: TAS. Frequency: Frequent (HP:0040282). (ORPHA:90033)
- Positive direct antiglobulin test (HP:0032366): A positive result of the direct antiglobulin test (DAT), a method of demonstrating the presence of antibody or complement bound to red blood cell (RBC) membranes by the use of anti-human globulin to form a visible agglutination reaction. Evidence: TAS. Frequency: Frequent (HP:0040282). (ORPHA:90033)
- Jaundice (HP:0000952): Yellow pigmentation of the skin due to bilirubin, which in turn is the result of increased bilirubin concentration in the bloodstream. Evidence: TAS. Frequency: Occasional (HP:0040283). (ORPHA:90033)
- Congestive heart failure (HP:0001635): The presence of an abnormality of cardiac function that is responsible for the failure of the heart to pump blood at a rate that is commensurate with the needs of the tissues or a state in which abnormally elevated filling pressures are required for the heart to do so. Heart failure is frequently related to a defect in myocardial contraction. Evidence: TAS. Frequency: Occasional (HP:0040283). (ORPHA:90033)
- Tachycardia (HP:0001649): A rapid heartrate that exceeds the range of the normal resting heartrate for age. Evidence: TAS. Frequency: Occasional (HP:0040283). (ORPHA:90033)
- Fever (HP:0001945): Body temperature elevated above the normal range. Evidence: TAS. Frequency: Occasional (HP:0040283). (ORPHA:90033)
- Systemic lupus erythematosus (HP:0002725): A chronic, relapsing, inflammatory, and often febrile multisystemic disorder of connective tissue, characterized principally by involvement of the skin, joints, kidneys, and serosal membranes. Evidence: TAS. Frequency: Occasional (HP:0040283). (ORPHA:90033)
- Chronic lymphatic leukemia (HP:0005550): A chronic lymphocytic/lymphatic/lymphoblastic leukemia (CLL) is a neoplastic disease characterized by proliferation and accumulation (blood, marrow and lymphoid organs) of morphologically mature but immunologically dysfunctional lymphocytes. A CLL is always a B-cell lymphocytic leukemia as there are no reports of cases of T-cell lymphocytic leukemias. Evidence: TAS. Frequency: Occasional (HP:0040283). (ORPHA:90033)
- Abnormal urinary color (HP:0012086): An abnormal color of the urine, that is, the color of the urine appears different from the usual straw-yellow color. Evidence: TAS. Frequency: Occasional (HP:0040283). (ORPHA:90033)
- Elevated jugular venous pressure (HP:0030848): Increased jugular venous pressure. Evidence: TAS. Frequency: Occasional (HP:0040283). (ORPHA:90033)
- Chest pain (HP:0100749): An unpleasant sensation characterized by physical discomfort (such as pricking, throbbing, or aching) localized to the chest. Evidence: TAS. Frequency: Occasional (HP:0040283). (ORPHA:90033)